- Radial head subluxation (HP:0003048): Partial dislocation of the head of the radius. Evidence: IEA. (OMIM:186400)
- Underdeveloped nasal alae (HP:0000430): Thinned, deficient, or excessively arched ala nasi. Evidence: IEA. (OMIM:186400)
- Metacarpophalangeal synostosis (HP:0005880): Fusion of a metacarpal bone with the proximal phalanx of the finger distal to it across the corresponding metacarpophalangeal joint. Evidence: IEA. (OMIM:186400)
- Short metacarpal (HP:0010049): Diminished length of one or more metacarpal bones in relation to the others of the same hand or to the contralateral metacarpal. Evidence: IEA. (OMIM:186400)
- Aplasia/Hypoplasia of the middle phalanges of the hand (HP:0009843). Evidence: IEA. (OMIM:186400)
- Tarsal synostosis (HP:0008368): Synostosis (bony fusion) involving one or more bones of the tarsus (calcaneus, talus, cuboid, navicular, cuneiiform bones). Evidence: IEA. (OMIM:186400)
- Carpal synostosis (HP:0009702): Synostosis (bony fusion) involving one or more bones of the carpus (scaphoid, lunate, triquetrum, trapezium, trapezoid, capitate, hamate, pisiform). Evidence: IEA. (OMIM:186400)
- Autosomal dominant inheritance (HP:0000006): A mode of inheritance that is observed for traits related to a gene encoded on one of the autosomes (i.e., the human chromosomes 1-22) in which a trait manifests in heterozygotes. In the context of medical genetics, an autosomal dominant disorder is caused when a single copy of the mutant allele is present. Males and females are affected equally, and can both transmit the disorder with a risk of 50% for each child of inheriting the mutant allele. Evidence: IEA. (OMIM:186400)
- Anonychia (HP:0001798): Aplasia of the nail. Evidence: IEA. (OMIM:186400)
These phenotypes are associated with the disease calcaneonavicular coalition (OMIM:186400).